- Diarrhea (HP:0002014): Abnormally increased frequency (usually defined as three or more) loose or watery bowel movements a day. Evidence: IEA. (OMIM:191390)
- Inflammation of the large intestine (HP:0002037): Inflammation, or an inflammatory state in the large intestine. Evidence: TAS. (OMIM:191390)
- Hematochezia (HP:0002573): The passage of fresh (red) blood per anus, usually in or with stools. Most rectal bleeding comes from the colon, rectum, or anus. Evidence: IEA. (OMIM:191390)
- Non-Mendelian inheritance (HP:0001426): A mode of inheritance that depends on genetic determinants in more than one gene. Evidence: IEA. (OMIM:191390)
- Weight loss (HP:0001824): Reduction of total body weight. Evidence: IEA. (OMIM:191390)
- Abdominal pain (HP:0002027): An unpleasant sensation characterized by physical discomfort (such as pricking, throbbing, or aching) and perceived to originate in the abdomen. Evidence: IEA. (OMIM:191390)
These phenotypes are associated with the disease inflammatory bowel disease 11 (OMIM:191390).